- Personality changes (HP:0000751): An abnormal shift in patterns of thinking, acting, or feeling. Evidence: TAS. Frequency: Occasional (HP:0040283). (ORPHA:99825)
- Seizure (HP:0001250): A seizure is an intermittent abnormality of nervous system physiology characterized by a transient occurrence of signs and/or symptoms due to abnormal excessive or synchronous neuronal activity in the brain. Evidence: TAS. Frequency: Frequent (HP:0040282). (ORPHA:99825)
- Coma (HP:0001259): The complete absence of wakefulness and consciousness, which is evident through a lack of response to any form of external stimuli. Evidence: TAS. Frequency: Occasional (HP:0040283). (ORPHA:99825)
- Myoclonus (HP:0001336): Very brief, involuntary random muscular contractions occurring at rest, in response to sensory stimuli, or accompanying voluntary movements. Evidence: TAS. Frequency: Frequent (HP:0040282). (ORPHA:99825)
- Tremor (HP:0001337): An unintentional, oscillating to-and-fro muscle movement about a joint axis. Evidence: TAS. Frequency: Frequent (HP:0040282). (ORPHA:99825)
- Fever (HP:0001945): Body temperature elevated above the normal range. Evidence: TAS. Frequency: Very frequent (HP:0040281). (ORPHA:99825)
- Nausea and vomiting (HP:0002017): Nausea is a commonly encountered symptom that has been defined as an unpleasant painless subjective feeling that one will imminently vomit. Vomiting has been defined as the forceful expulsion of the contents of the stomach, duodenum, or jejunum through the oral cavity. While nausea and vomiting are often thought to exist on a temporal continuum, this is not always the case. There are situations when severe nausea may be present without emesis and less frequently, when emesis may be present without preceding nausea. Evidence: TAS. Frequency: Very frequent (HP:0040281). (ORPHA:99825)
- Anorexia (HP:0002039): Lack of desire to eat (loss of appetite). Evidence: TAS. Frequency: Very frequent (HP:0040281). (ORPHA:99825)
- Respiratory distress (HP:0002098): Respiratory distress is objectively observable as the physical or emotional consequences from the experience of dyspnea. The physical presentation of respiratory distress is generally referred to as labored breathing, while the sensation of respiratory distress is called shortness of breath or dyspnea. Evidence: TAS. Frequency: Occasional (HP:0040283). (ORPHA:99825)
- Headache (HP:0002315): Cephalgia, or pain sensed in various parts of the head, not confined to the area of distribution of any nerve. Evidence: TAS. Frequency: Very frequent (HP:0040281). (ORPHA:99825)
- Vertigo (HP:0002321): An abnormal sensation of spinning while the body is actually stationary. Evidence: TAS. Frequency: Frequent (HP:0040282). (ORPHA:99825)
- Infectious encephalitis (HP:0002383): A disorder of the brain caused by an infectious agent that presents with fever, headache, and an altered level of consciousness. There may also be focal or multifocal neurologic deficits, and focal or generalized seizure activity. Evidence: TAS. Frequency: Frequent (HP:0040282). (ORPHA:99825)
- Hypotension (HP:0002615): Low Blood Pressure, vascular hypotension. Evidence: TAS. Frequency: Occasional (HP:0040283). (ORPHA:99825)
- Myalgia (HP:0003326): Pain in muscle. Evidence: TAS. Frequency: Very frequent (HP:0040281). (ORPHA:99825)
- Fatigue (HP:0012378): A subjective feeling of tiredness characterized by a lack of energy and motivation. Evidence: TAS. Frequency: Very frequent (HP:0040281). (ORPHA:99825)
- Cough (HP:0012735): A sudden, audible expulsion of air from the lungs through a partially closed glottis, preceded by inhalation. Evidence: TAS. Frequency: Occasional (HP:0040283). (ORPHA:99825)
- Recurrent pharyngitis (HP:0100776): Increased susceptibility to pharyngitis, as manifested by recurrent episodes of pharyngeal infection that are unusual in frequency or severity for a healthy individual of the same age. Evidence: TAS. Frequency: Very frequent (HP:0040281). (ORPHA:99825)
These phenotypes are associated with the disease Nipah virus disease (ORPHA:99825).